Phenotypes associated with the disease Catecholaminergic polymorphic ventricular tachycardia (ORPHA:3286):
- Ventricular tachycardia (HP:0004756): A tachycardia originating in the ventricles characterized by rapid heart rate (over 100 beats per minute) and broad QRS complexes (over 120 ms). Evidence: TAS. Frequency: Very frequent (HP:0040281). (ORPHA:3286)
- Cardiac arrest (HP:0001695): An abrupt loss of heart function. Evidence: TAS. Frequency: Frequent (HP:0040282). (ORPHA:3286)
- Palpitations (HP:0001962): A sensation that the heart is pounding or racing, which is a non-specific sign but may be a manifestation of arrhythmia. Evidence: TAS. Frequency: Frequent (HP:0040282). (ORPHA:3286)
- Vertigo (HP:0002321): An abnormal sensation of spinning while the body is actually stationary. Evidence: TAS. Frequency: Frequent (HP:0040282). (ORPHA:3286)
- Supraventricular tachycardia (HP:0004755): Supraventricular tachycardia (SVT) is an abnormally increased heart rate (over 100 beats per minute at rest) with origin above the level of the ventricles. Evidence: TAS. Frequency: Frequent (HP:0040282). (ORPHA:3286)
- Atrial fibrillation (HP:0005110): An atrial arrhythmia characterized by disorganized atrial activity without discrete P waves on the surface EKG, but instead by an undulating baseline or more sharply circumscribed atrial deflections of varying amplitude an frequency ranging from 350 to 600 per minute. Evidence: TAS. Frequency: Frequent (HP:0040282). (ORPHA:3286)
- Polymorphic ventricular tachycardia (HP:0031677): A type of ventricular tachycardia that is characterized by variable QRS complexes within each lead (i.e., QRS complexes may be different from beat to beat). Evidence: TAS. Frequency: Frequent (HP:0040282). (ORPHA:3286)
- Syncope (HP:0001279): A transient loss of consciousness (i.e., characterized by a rapid onset, a short duration, and a spontaneous and complete recovery) due to cerebral hypoperfusion. Evidence: TAS. Frequency: Occasional (HP:0040283). (ORPHA:3286)
- Sudden cardiac death (HP:0001645): The heart suddenly and unexpectedly stops beating resulting in death within a short time period (generally within 1 h of symptom onset). Evidence: TAS. Frequency: Occasional (HP:0040283). (ORPHA:3286)
- Ventricular fibrillation (HP:0001663): Uncontrolled contractions of muscles fibers in the left ventricle not producing contraction of the left ventricle. Ventricular fibrillation usually begins with a ventricular premature contraction and a short run of rapid ventricular tachycardia degenerating into uncoordinating ventricular fibrillations. Evidence: TAS. Frequency: Occasional (HP:0040283). (ORPHA:3286)